- Abnormal placenta morphology (HP:0100767): An abnormality of the placenta, the organ that connects the developing fetus to the uterine wall to enable nutrient uptake, waste elimination, and gas exchange. Evidence: TAS. Frequency: Obligate (HP:0040280). (ORPHA:439167)
- Intrauterine growth retardation (HP:0001511): An abnormal restriction of fetal growth with fetal weight below the tenth percentile for gestational age. Evidence: TAS. Frequency: Very frequent (HP:0040281). (ORPHA:439167)
- Small for gestational age (HP:0001518): Smaller than normal size according to sex and gestational age related norms, defined as a weight below the 10th percentile for the gestational age. Evidence: TAS. Frequency: Very frequent (HP:0040281). (ORPHA:439167)
- Proportionate short stature (HP:0003508): A kind of short stature in which different regions of the body are shortened to a comparable extent. Evidence: TAS. Frequency: Very frequent (HP:0040281). (ORPHA:439167)
- Small placenta (HP:0006266): Reduced size of the placenta. Evidence: TAS. Frequency: Very frequent (HP:0040281). (ORPHA:439167)
- Abnormal umbilical cord blood vessel morphology (HP:0011403). Evidence: TAS. Frequency: Very frequent (HP:0040281). (ORPHA:439167)
- Hypoxemia (HP:0012418): An abnormally low level of blood oxygen. Evidence: TAS. Frequency: Very frequent (HP:0040281). (ORPHA:439167)
- Autism (HP:0000717): Autism is a neurodevelopmental disorder characterized by impaired social interaction and communication, and by restricted and repetitive behavior. Autism begins in childhood. It is marked by the presence of markedly abnormal or impaired development in social interaction and communication and a markedly restricted repertoire of activity and interest. Manifestations of the disorder vary greatly depending on the developmental level and chronological age of the individual (DSM-IV). Evidence: TAS. Frequency: Frequent (HP:0040282). (ORPHA:439167)
- Autistic behavior (HP:0000729): Persistent deficits in social interaction and communication and interaction as well as a markedly restricted repertoire of activity and interest as well as repetitive patterns of behavior. Evidence: TAS. Frequency: Frequent (HP:0040282). (ORPHA:439167)
- Systemic lupus erythematosus (HP:0002725): A chronic, relapsing, inflammatory, and often febrile multisystemic disorder of connective tissue, characterized principally by involvement of the skin, joints, kidneys, and serosal membranes. Evidence: TAS. Frequency: Frequent (HP:0040282). (ORPHA:439167)
- Antiphospholipid antibody positivity (HP:0003613): The presence of circulating autoantibodies to phospholipids. Evidence: TAS. Frequency: Frequent (HP:0040282). (ORPHA:439167)
- Neurodevelopmental abnormality (HP:0012759): A deviation from normal of the neurological development of a child, which may include any or all of the aspects of the development of personal, social, gross or fine motor, and cognitive abilities. Evidence: TAS. Frequency: Frequent (HP:0040282). (ORPHA:439167)
- Insulin resistance (HP:0000855): Increased resistance towards insulin, that is, diminished effectiveness of insulin in reducing blood glucose levels. Evidence: TAS. Frequency: Occasional (HP:0040283). (ORPHA:439167)
- Abnormal heart morphology (HP:0001627): Any structural anomaly of the heart. Evidence: TAS. Frequency: Occasional (HP:0040283). (ORPHA:439167)
- Abnormal lung morphology (HP:0002088): Any structural anomaly of the lung. Evidence: TAS. Frequency: Occasional (HP:0040283). (ORPHA:439167)
- Miscarriage (HP:0005268): A pregnancy that ends at a stage in which the fetus is incapable of surviving on its own, defined as the spontaneous loss of a fetus before the 22th week of pregnancy. Evidence: TAS. Frequency: Occasional (HP:0040283). (ORPHA:439167)
- Maternal hypertension (HP:0008071): Increased blood pressure during a pregnancy. Evidence: TAS. Frequency: Occasional (HP:0040283). (ORPHA:439167)
- Cerebral palsy (HP:0100021): Cerebral palsy describes a group of permanent disorders of the development of movement and posture, causing activity limitation, that are attributed to nonprogressive disturbances that occurred in the developing fetal or infant brain. The motor disorders of cerebral palsy are often accompanied by disturbances of sensation, perception, cognition, communication, and behavior, by epilepsy, and by secondary musculoskeletal problems. Evidence: TAS. Frequency: Occasional (HP:0040283). (ORPHA:439167)
- Eclampsia (HP:0100601): An acute and life-threatening complication of pregnancy, which is characterized by the appearance of tonic-clonic seizures, usually in a patient who had developed pre-eclampsia. Eclampsia includes seizures and coma that happen during pregnancy but are not due to preexisting or organic brain disorders. Evidence: TAS. Frequency: Occasional (HP:0040283). (ORPHA:439167)
- Preeclampsia (HP:0100602): Pregnancy-induced hypertension in association with significant amounts of protein in the urine. Evidence: TAS. Frequency: Occasional (HP:0040283). (ORPHA:439167)
These phenotypes are associated with the disease Placental insufficiency (ORPHA:439167).